Phenotypes associated with the disease hypotrichosis 15 (OMIM:620177):
- Sparse scalp hair (HP:0002209): Decreased number of hairs per unit area of skin of the scalp. Evidence: PCS. Frequency: 4/4. (PMID:32336749)
- Autosomal recessive inheritance (HP:0000007): A mode of inheritance that is observed for traits related to a gene encoded on one of the autosomes (i.e., the human chromosomes 1-22) in which a trait manifests in individuals with two pathogenic alleles, either homozygotes (two copies of the same mutant allele) or compound heterozygotes (whereby each copy of a gene has a distinct mutant allele). Evidence: PCS. (PMID:32336749)